Phenotypes associated with the disease corneal dystrophy, Fuchs endothelial, 8 (OMIM:615523):
- Corneal dystrophy (HP:0001131): The term corneal dystrophy embraces a heterogenous group of bilateral genetically determined non-inflammatory corneal diseases that are restricted to the cornea. Evidence: PCS. (PMID:24094747)
- Adult onset (HP:0003581): Onset of disease manifestations in adulthood, defined here as at the age of 16 years or later. Evidence: PCS. (PMID:24094747)
- Corneal guttata (HP:0012038): Corneal guttata are droplet-like accumulations of non-banded collagen on the posterior surface of Descemet's membrane. The presence of focal thickenings of Descemet's membrane histologically named guttae. Cornea guttata can be easily diagnosed in vivo and ex vivo by means of specular microscopy as it gives dark areas where no endothelial cells are visible. Evidence: PCS. Frequency: 12/12. (PMID:24094747)
- Autosomal dominant inheritance (HP:0000006): A mode of inheritance that is observed for traits related to a gene encoded on one of the autosomes (i.e., the human chromosomes 1-22) in which a trait manifests in heterozygotes. In the context of medical genetics, an autosomal dominant disorder is caused when a single copy of the mutant allele is present. Males and females are affected equally, and can both transmit the disorder with a risk of 50% for each child of inheriting the mutant allele. Evidence: PCS. (PMID:24094747)